- Hearing impairment (HP:0000365): A decreased magnitude of the sensory perception of sound. Evidence: IEA. (OMIM:615649)
- Autosomal dominant inheritance (HP:0000006): A mode of inheritance that is observed for traits related to a gene encoded on one of the autosomes (i.e., the human chromosomes 1-22) in which a trait manifests in heterozygotes. In the context of medical genetics, an autosomal dominant disorder is caused when a single copy of the mutant allele is present. Males and females are affected equally, and can both transmit the disorder with a risk of 50% for each child of inheriting the mutant allele. Evidence: TAS. (OMIM:615649)
These phenotypes are associated with the disease autosomal dominant nonsyndromic hearing loss 54 (OMIM:615649).